- Spastic ataxia (HP:0002497). Evidence: IEA. (OMIM:271320)
- Corneal dystrophy (HP:0001131): The term corneal dystrophy embraces a heterogenous group of bilateral genetically determined non-inflammatory corneal diseases that are restricted to the cornea. Evidence: IEA. (OMIM:271320)
- Developmental cataract (HP:0000519): A cataract that occurs congenitally as the result of a developmental defect, in contrast to the majority of cataracts that occur in adulthood as the result of degenerative changes of the lens. Evidence: IEA. (OMIM:271320)
- Autosomal recessive inheritance (HP:0000007): A mode of inheritance that is observed for traits related to a gene encoded on one of the autosomes (i.e., the human chromosomes 1-22) in which a trait manifests in individuals with two pathogenic alleles, either homozygotes (two copies of the same mutant allele) or compound heterozygotes (whereby each copy of a gene has a distinct mutant allele). Evidence: IEA. (OMIM:271320)
- Spinocerebellar tract degeneration (HP:0002503). Evidence: IEA. (OMIM:271320)
- Myopia (HP:0000545): An abnormality of refraction characterized by the ability to see objects nearby clearly, while objects in the distance appear blurry. Evidence: IEA. (OMIM:271320)
These phenotypes are associated with the disease spastic ataxia-corneal dystrophy syndrome (OMIM:271320).